Phenotypes associated with the disease early-onset non-syndromic cataract (OMIM:601371):
- Nuclear cataract (HP:0100018): A nuclear cataract is an opacity or clouding that develops in the lens nucleus. That is, a nuclear cataract is one that is located in the center of the lens. The nucleus tends to darken changing from clear to yellow and sometimes brown. Evidence: TAS. (OMIM:601371)
- Autosomal recessive inheritance (HP:0000007): A mode of inheritance that is observed for traits related to a gene encoded on one of the autosomes (i.e., the human chromosomes 1-22) in which a trait manifests in individuals with two pathogenic alleles, either homozygotes (two copies of the same mutant allele) or compound heterozygotes (whereby each copy of a gene has a distinct mutant allele). Evidence: TAS. (OMIM:601371)